Phenotypes associated with the disease Sydenham chorea (ORPHA:306731):
- Movement abnormality of the tongue (HP:0000182). Evidence: TAS. Frequency: Frequent (HP:0040282). (ORPHA:306731)
- Facial grimacing (HP:0000273). Evidence: TAS. Frequency: Frequent (HP:0040282). (ORPHA:306731)
- Atypical behavior (HP:0000708): Atypical behavior is an abnormality in a person's actions that can be controlled or modulated by the will of the individual. While abnormal behaviors can be difficult to control, they are distinct from other abnormal actions that cannot be affected by the individual's will. Evidence: TAS. Frequency: Frequent (HP:0040282). (ORPHA:306731)
- Emotional lability (HP:0000712): Unstable emotional experiences and frequent mood changes; emotions that are easily aroused, intense, and/or disproportionate to events and circumstances. Evidence: TAS. Frequency: Frequent (HP:0040282). (ORPHA:306731)
- Inappropriate behavior (HP:0000719): An explicit or perceived action, demonstration, conduct, or language (verbal and written) that is contrary to generally accepted norms, rules, procedures, or unacceptable within the context in which it is carried out. Inappropriate behaviors could take place in a sexual or social context and could be aggressive, violent, impulsive, intimidating, or threatening in nature. Evidence: TAS. Frequency: Frequent (HP:0040282). (ORPHA:306731)
- Compulsive behaviors (HP:0000722): Behavior that consists of repetitive acts, characterized by the feeling that one "has to" perform them, while being aware that these acts are not in line with one's overall goal. Evidence: TAS. Frequency: Frequent (HP:0040282). (ORPHA:306731)
- Irritability (HP:0000737): An emotional state characterized by negative feelings of heightened frustration, annoyance, or feeling upset, often triggered by internal factors (e.g., fatigue, hunger, unfulfilled desires) or external factors (e.g., social or environmental challenges). Irritability may be unpredictable, and is accompanied by a lowered threshold for emotional reactivity and observable features (speech, facial expressions, or psychomotor activity). Evidence: TAS. Frequency: Frequent (HP:0040282). (ORPHA:306731)
- Dysarthria (HP:0001260): Dysarthric speech is a general description referring to a neurological speech disorder characterized by poor articulation. Depending on the involved neurological structures, dysarthria may be further classified as spastic, flaccid, ataxic, hyperkinetic and hypokinetic, or mixed. Evidence: TAS. Frequency: Frequent (HP:0040282). (ORPHA:306731)
- Generalized hypotonia (HP:0001290): Generalized muscular hypotonia (abnormally low muscle tone). Evidence: TAS. Frequency: Frequent (HP:0040282). (ORPHA:306731)
- Chorea (HP:0002072): Chorea (Greek for 'dance') refers to widespread arrhythmic involuntary movements of a forcible, jerky and restless fashion. It is a random-appearing sequence of one or more discrete involuntary movements or movement fragments. Movements appear random because of variability in timing, duration or location. Each movement may have a distinct start and end. However, movements may be strung together and thus may appear to flow randomly from one muscle group to another. Chorea can involve the trunk, neck, face, tongue, and extremities. Evidence: TAS. Frequency: Frequent (HP:0040282). (ORPHA:306731)
- Headache (HP:0002315): Cephalgia, or pain sensed in various parts of the head, not confined to the area of distribution of any nerve. Evidence: TAS. Frequency: Frequent (HP:0040282). (ORPHA:306731)
- Unsteady gait (HP:0002317). Evidence: TAS. Frequency: Frequent (HP:0040282). (ORPHA:306731)
- Hemiballismus (HP:0100248): Hemiballismus is a rare movement disorder that is caused primarily by damage to various areas in the basal ganglia. Hemiballismus is usually characterized by involuntary flinging motions of the extremities. The movements are often violent and have wide amplitudes of motion. They are continuous and random and can involve proximal and/or distal muscles on one side of the body, while some cases even include the facial muscles. The more a patient is active, the more the movements increase. With relaxation comes a decrease in movements. Evidence: TAS. Frequency: Frequent (HP:0040282). (ORPHA:306731)
- Septic arthritis (HP:0003095). Evidence: TAS. Frequency: Occasional (HP:0040283). (ORPHA:306731)
- Recurrent streptococcus pneumoniae infections (HP:0005366): Increased susceptibility to streptococcus pneumoniae infections as manifested by a history of recurrent infections by streptococcus pneumoniae. Evidence: TAS. Frequency: Occasional (HP:0040283). (ORPHA:306731)
- Erythema (HP:0010783): Redness of the skin, caused by hyperemia of the capillaries in the lower layers of the skin. Evidence: TAS. Frequency: Occasional (HP:0040283). (ORPHA:306731)
- Endocarditis (HP:0100584): An inflammation of the endocardium, the inner layer of the heart, which usually involves the heart valves. Evidence: TAS. Frequency: Occasional (HP:0040283). (ORPHA:306731)